Phenotypes associated with the disease Meckel diverticulum (OMIM:155140):
- Meckel diverticulum (HP:0002245): Meckel's diverticulum is a congenital diverticulum located in the distal ileum. Evidence: IEA. (OMIM:155140)
- Autosomal dominant inheritance (HP:0000006): A mode of inheritance that is observed for traits related to a gene encoded on one of the autosomes (i.e., the human chromosomes 1-22) in which a trait manifests in heterozygotes. In the context of medical genetics, an autosomal dominant disorder is caused when a single copy of the mutant allele is present. Males and females are affected equally, and can both transmit the disorder with a risk of 50% for each child of inheriting the mutant allele. Evidence: IEA. (OMIM:155140)